Phenotypes associated with the disease orofaciodigital syndrome 16 (OMIM:617563):
- Congenital onset (HP:0003577): A phenotypic abnormality that is present at birth. Evidence: PCS. Frequency: 1/1. (PMID:26518474)
- Inability to walk (HP:0002540): Incapability to ambulate. Evidence: IEA. (OMIM:617563)
- Inguinal hernia (HP:0000023): Protrusion of the contents of the abdominal cavity through the inguinal canal. Evidence: PCS. Frequency: 1/1. (PMID:26518474)
- Postaxial hand polydactyly (HP:0001162): Supernumerary digits located at the ulnar side of the hand (that is, on the side with the fifth finger). Evidence: PCS. Frequency: 1/1. (PMID:26518474)
- Hypotonia (HP:0001252): Hypotonia is an abnormally low muscle tone (the amount of tension or resistance to movement in a muscle). Even when relaxed, muscles have a continuous and passive partial contraction which provides some resistance to passive stretching. Hypotonia thus manifests as diminished resistance to passive stretching. Hypotonia is not the same as muscle weakness, although the two conditions can co-exist. Evidence: PCS. Frequency: 1/1. (PMID:26518474)
- Global developmental delay (HP:0001263): A delay in the achievement of motor or mental milestones in the domains of development of a child, including motor skills, speech and language, cognitive skills, and social and emotional skills. This term should only be used to describe children younger than five years of age. Evidence: PCS. Frequency: 1/1. (PMID:26518474)
- Ataxia (HP:0001251): Ataxia refers to impaired coordination of voluntary muscle movement. Cerebellar ataxia refers to ataxia due to dysfunction of the cerebellum. This causes a variety of elementary neurological deficits including asynergy (lack of coordination between muscles, limbs and joints), dysmetria (lack of ability to judge distances that can lead to under- or overshoot in grasping movements), and dysdiadochokinesia (inability to perform rapid movements requiring antagonizing muscle groups to be switched on and off repeatedly). Evidence: IEA. (OMIM:617563)
- Short palpebral fissure (HP:0012745): Distance between the medial and lateral canthi is more than 2 SD below the mean for age (objective); or, apparently reduced length of the palpebral fissures. Evidence: PCS. Frequency: 1/1. (PMID:26518474)
- Gray matter heterotopia (HP:0002282): Heterotopia or neuronal heterotopia are macroscopic clusters of misplaced neurons (gray matter), most often situated along the ventricular walls or within the subcortical white matter. Evidence: IEA. (OMIM:617563)
- Motor delay (HP:0001270): A type of Developmental delay characterized by a delay in acquiring motor skills. Evidence: PCS. Frequency: 1/1. (PMID:26518474)
- Hamartoma of tongue (HP:0011802): A benign (noncancerous) tumorlike malformation made up of an abnormal mixture of cells and tissues that originates in the tongue. Evidence: IEA. (OMIM:617563)
- Depressed nasal bridge (HP:0005280): Posterior positioning of the nasal root in relation to the overall facial profile for age. Evidence: PCS. Frequency: 1/1. (PMID:26518474)
- Severe intellectual disability (HP:0010864): Severe intellectual disability (ID) is defined as a type of ID characterized by severely sub-average adaptive functioning and intellectual functioning, with an intelligence quotient (IQ) the range of 20-34. Evidence: IEA. (OMIM:617563)
- Ptosis (HP:0000508): The upper eyelid margin is positioned 3 mm or more lower than usual and covers the superior portion of the iris (objective); or, the upper lid margin obscures at least part of the pupil (subjective). Evidence: IEA. (OMIM:617563)
- Oculomotor apraxia (HP:0000657): Ocular motor apraxia is a deficiency in voluntary, horizontal, lateral, fast eye movements (saccades) with retention of slow pursuit movements. The inability to follow objects visually is often compensated by head movements. There may be decreased smooth pursuit, and cancelation of the vestibulo-ocular reflex. Evidence: IEA. (OMIM:617563)
- Molar tooth sign on MRI (HP:0002419): An abnormal appearance of the midbrain in axial magnetic resonance imaging in which the elongated superior cerebellar peduncles give the midbrain an appearance reminiscent of a molar or wisdom tooth. Evidence: IEA. Frequency: 0/1. (OMIM:617563)
- Autosomal recessive inheritance (HP:0000007): A mode of inheritance that is observed for traits related to a gene encoded on one of the autosomes (i.e., the human chromosomes 1-22) in which a trait manifests in individuals with two pathogenic alleles, either homozygotes (two copies of the same mutant allele) or compound heterozygotes (whereby each copy of a gene has a distinct mutant allele). Evidence: PCS. (PMID:26518474)
- Ventriculomegaly (HP:0002119): An increase in size of the ventricular system of the brain. Evidence: IEA. (OMIM:617563)
- Retinopathy (HP:0000488): Any noninflammatory disease of the retina. This nonspecific term is retained here because of its wide use in the literature, but if possible new annotations should indicate the precise type of retinal abnormality. Evidence: IEA. (OMIM:617563)
- Postaxial foot polydactyly (HP:0001830): Polydactyly of the foot most commonly refers to the presence of six toes on one foot. Postaxial polydactyly affects the lateral ray and the duplication may range from a well-formed articulated digit to a rudimentary digit. Evidence: PCS. Frequency: 1/1. (PMID:26518474)
- Retrognathia (HP:0000278): An abnormality in which the mandible is mislocalised posteriorly. Evidence: PCS. Frequency: 1/1. (PMID:26518474)
- Low-set ears (HP:0000369): Upper insertion of the ear to the scalp below an imaginary horizontal line drawn between the inner canthi of the eye and extending posteriorly to the ear. Evidence: PCS. Frequency: 1/1. (PMID:26518474)
- Apnea (HP:0002104): Lack of breathing with no movement of the respiratory muscles and no exchange of air in the lungs. This term refers to a disposition to have recurrent episodes of apnea rather than to a single event. Evidence: IEA. (OMIM:617563)